- Permanent atrial fibrillation (HP:0004754): Atrial fibrillation (AF) that cannot be successfully terminated by cardioversion, and longstanding (more than 1 year) AF, where cardioversion is not indicated or has not been attempted, is termed permanent. Evidence: PCS. Frequency: 2/7. (PMID:15922306)
- Middle age onset (HP:0003596): A type of adult onset with onset of symptoms at the age of 40 to 60 years. Evidence: PCS. Frequency: 5/5. (PMID:15922306)
- Prolonged QTc interval (HP:0005184): A longer than normal interval (corrected for heart rate) between the Q and T waves in the heart's cycle. Prolonged QTc can cause premature action potentials during late phase depolarizations thereby leading to ventricular arrhythmias and ventricular fibrillations. Evidence: PCS. Frequency: 0/7. (PMID:15922306)
- Palpitations (HP:0001962): A sensation that the heart is pounding or racing, which is a non-specific sign but may be a manifestation of arrhythmia. Evidence: PCS. Frequency: 4/7. (PMID:15922306)
- Paroxysmal atrial fibrillation (HP:0004757): Episodes of atrial fibrillation that typically last for several hours up to one day and terminate spontaneously. Evidence: PCS. Frequency: 3/7. (PMID:15922306)
- Syncope (HP:0001279): A transient loss of consciousness (i.e., characterized by a rapid onset, a short duration, and a spontaneous and complete recovery) due to cerebral hypoperfusion. Evidence: PCS. Frequency: 0/7. (PMID:15922306)
- Autosomal dominant inheritance (HP:0000006): A mode of inheritance that is observed for traits related to a gene encoded on one of the autosomes (i.e., the human chromosomes 1-22) in which a trait manifests in heterozygotes. In the context of medical genetics, an autosomal dominant disorder is caused when a single copy of the mutant allele is present. Males and females are affected equally, and can both transmit the disorder with a risk of 50% for each child of inheriting the mutant allele. Evidence: PCS. (PMID:15922306)
These phenotypes are associated with the disease atrial fibrillation, familial, 9 (OMIM:613980).